Phenotypes associated with the disease inflammatory bowel disease 3 (OMIM:604519):
- Ulcerative colitis (HP:0100279): A chronic inflammatory bowel disease that includes characteristic ulcers, or open sores, in the colon. The main symptom of active disease is usually constant diarrhea mixed with blood, of gradual onset and intermittent periods of exacerbated symptoms contrasting with periods that are relatively symptom-free. In contrast to Crohn's disease this special form of colitis begins in the distal parts of the rectum, spreads continually upwards and affects only mucose and submucose tissue of the colon. Evidence: TAS. (OMIM:604519)
- Autosomal dominant inheritance (HP:0000006): A mode of inheritance that is observed for traits related to a gene encoded on one of the autosomes (i.e., the human chromosomes 1-22) in which a trait manifests in heterozygotes. In the context of medical genetics, an autosomal dominant disorder is caused when a single copy of the mutant allele is present. Males and females are affected equally, and can both transmit the disorder with a risk of 50% for each child of inheriting the mutant allele. Evidence: TAS. (OMIM:604519)